Phenotypes associated with the disease Benign recurrent intrahepatic cholestasis (ORPHA:65682):
- Hearing impairment (HP:0000365): A decreased magnitude of the sensory perception of sound. Evidence: TAS. Frequency: Occasional (HP:0040283). (ORPHA:65682)
- Jaundice (HP:0000952): Yellow pigmentation of the skin due to bilirubin, which in turn is the result of increased bilirubin concentration in the bloodstream. Evidence: TAS. Frequency: Very frequent (HP:0040281). (ORPHA:65682)
- Pruritus (HP:0000989): Pruritus is an itch or a sensation that makes a person want to scratch. This term refers to an abnormally increased disposition to experience pruritus. Evidence: TAS. Frequency: Very frequent (HP:0040281). (ORPHA:65682)
- Cholelithiasis (HP:0001081): Hard, pebble-like deposits that form within the gallbladder. Evidence: TAS. Frequency: Occasional (HP:0040283). (ORPHA:65682)
- Cirrhosis (HP:0001394): A chronic disorder of the liver in which liver tissue becomes scarred and is partially replaced by regenerative nodules and fibrotic tissue resulting in loss of liver function. Evidence: TAS. Frequency: Occasional (HP:0040283). (ORPHA:65682)
- Hepatocellular carcinoma (HP:0001402): A kind of neoplasm of the liver that originates in hepatocytes and presents macroscopically as a soft and hemorrhagic tan mass in the liver. Evidence: TAS. Frequency: Occasional (HP:0040283). (ORPHA:65682)
- Pancreatitis (HP:0001733): The presence of inflammation in the pancreas. Evidence: TAS. Frequency: Occasional (HP:0040283). (ORPHA:65682)
- Weight loss (HP:0001824): Reduction of total body weight. Evidence: TAS. Frequency: Very frequent (HP:0040281). (ORPHA:65682)
- Nausea and vomiting (HP:0002017): Nausea is a commonly encountered symptom that has been defined as an unpleasant painless subjective feeling that one will imminently vomit. Vomiting has been defined as the forceful expulsion of the contents of the stomach, duodenum, or jejunum through the oral cavity. While nausea and vomiting are often thought to exist on a temporal continuum, this is not always the case. There are situations when severe nausea may be present without emesis and less frequently, when emesis may be present without preceding nausea. Evidence: TAS. Frequency: Frequent (HP:0040282). (ORPHA:65682)
- Abdominal pain (HP:0002027): An unpleasant sensation characterized by physical discomfort (such as pricking, throbbing, or aching) and perceived to originate in the abdomen. Evidence: TAS. Frequency: Occasional (HP:0040283). (ORPHA:65682)
- Chronic diarrhea (HP:0002028): The presence of chronic diarrhea, which is usually taken to mean diarrhea that has persisted for over 4 weeks. Evidence: TAS. Frequency: Occasional (HP:0040283). (ORPHA:65682)
- Anorexia (HP:0002039): Lack of desire to eat (loss of appetite). Evidence: TAS. Frequency: Very frequent (HP:0040281). (ORPHA:65682)
- Cholestatic liver disease (HP:0002611). Evidence: TAS. Frequency: Very frequent (HP:0040281). (ORPHA:65682)
- Elevated circulating hepatic transaminase concentration (HP:0002910): Elevations of the levels of SGOT and SGPT in the serum. SGOT (serum glutamic oxaloacetic transaminase) and SGPT (serum glutamic pyruvic transaminase) are transaminases primarily found in the liver and heart and are released into the bloodstream as the result of liver or heart damage. SGOT and SGPT are used clinically mainly as markers of liver damage. Evidence: TAS. Frequency: Very frequent (HP:0040281). (ORPHA:65682)
- Acholic stools (HP:0011985): Clay colored stools lacking bile pigment. Evidence: TAS. Frequency: Very frequent (HP:0040281). (ORPHA:65682)
- Fatigue (HP:0012378): A subjective feeling of tiredness characterized by a lack of energy and motivation. Evidence: TAS. Frequency: Very frequent (HP:0040281). (ORPHA:65682)